Phenotypes associated with the disease Abetalipoproteinemia (ORPHA:14):
- Abnormality of the nervous system (HP:0000707): An abnormality of the nervous system. Evidence: TAS. Frequency: Very frequent (HP:0040281). (ORPHA:14)
- Acanthocytosis (HP:0001927): Acanthocytosis is a type of poikilocytosis characterized by the presence of spikes on the cell surface. The cells have an irregular shape resembling many-pointed stars. Evidence: TAS. Frequency: Very frequent (HP:0040281). (ORPHA:14)
- Steatorrhea (HP:0002570): Greater than normal amounts of fat in the feces. This is a result of malabsorption of lipids in the small intestine and results in frothy foul-smelling fecal matter that floats. Evidence: TAS. Frequency: Very frequent (HP:0040281). (ORPHA:14)
- Fat malabsorption (HP:0002630): Abnormality of the absorption of fat from the gastrointestinal tract. Evidence: TAS. Frequency: Very frequent (HP:0040281). (ORPHA:14)
- Abnormal circulating apolipoprotein concentration (HP:0025201): Any deviation from the normal concentration of apolipoprotein in the blood circulation. Evidence: TAS. Frequency: Very frequent (HP:0040281). (ORPHA:14)
- Decreased circulating vitamin E concentration (HP:0100513): A reduced concentration of vitamin E in the blood circulation. Vitamin E is a lipophilic vitamin that is also known as alpha-tocopherol. Evidence: TAS. Frequency: Very frequent (HP:0040281). (ORPHA:14)
- Progressive visual loss (HP:0000529): A reduction of previously attained ability to see. Evidence: TAS. Frequency: Frequent (HP:0040282). (ORPHA:14)
- Color vision defect (HP:0000551): An anomaly in the ability to discriminate between or recognize colors. Evidence: TAS. Frequency: Frequent (HP:0040282). (ORPHA:14)
- Nyctalopia (HP:0000662): Inability to see well at night or in poor light. Evidence: TAS. Frequency: Frequent (HP:0040282). (ORPHA:14)
- Areflexia (HP:0001284): Absence of neurologic reflexes such as the knee-jerk reaction. Evidence: TAS. Frequency: Frequent (HP:0040282). (ORPHA:14)
- Failure to thrive (HP:0001508): Failure to thrive (FTT) refers to a child whose physical growth is substantially below the norm. Evidence: TAS. Frequency: Frequent (HP:0040282). (ORPHA:14)
- Anemia (HP:0001903): A reduction in erythrocytes volume or hemoglobin concentration. Evidence: TAS. Frequency: Frequent (HP:0040282). (ORPHA:14)
- Reticulocytosis (HP:0001923): An elevation in the number of reticulocytes (immature erythrocytes) in the peripheral blood circulation. Evidence: TAS. Frequency: Frequent (HP:0040282). (ORPHA:14)
- Chronic diarrhea (HP:0002028): The presence of chronic diarrhea, which is usually taken to mean diarrhea that has persisted for over 4 weeks. Evidence: TAS. Frequency: Frequent (HP:0040282). (ORPHA:14)
- Hyperbilirubinemia (HP:0002904): An increased amount of bilirubin in the blood. Evidence: TAS. Frequency: Frequent (HP:0040282). (ORPHA:14)
- Hypoalbuminemia (HP:0003073): The concentration of albumin in the blood circulation is below the lower limit of normal. Evidence: TAS. Frequency: Frequent (HP:0040282). (ORPHA:14)
- Hypocholesterolemia (HP:0003146): An decreased concentration of cholesterol in the blood. Evidence: TAS. Frequency: Frequent (HP:0040282). (ORPHA:14)
- Decreased circulating HDL-C concentration (HP:0003233): The concentration of high-density lipoprotein cholesterol in the blood circulation is below the lower limit of normal. Evidence: TAS. Frequency: Frequent (HP:0040282). (ORPHA:14)
- Myalgia (HP:0003326): Pain in muscle. Evidence: TAS. Frequency: Frequent (HP:0040282). (ORPHA:14)
- Decreased circulating LDL-C concentration (HP:0003563): The concentration of low-density lipoprotein cholesterol in the blood circulation is below the lower limit of normal. Evidence: TAS. Frequency: Frequent (HP:0040282). (ORPHA:14)
- Reduced circulating vitamin A concentration (HP:0004905): Concentration of vitamin A below the lower limit of normal in the blood circulation. Evidence: TAS. Frequency: Frequent (HP:0040282). (ORPHA:14)
- Abnormal retinal pigmentation (HP:0007703): Any deviation from the normal pigmentation of the retina. Evidence: TAS. Frequency: Frequent (HP:0040282). (ORPHA:14)
- Hypotriglyceridemia (HP:0012153): An decrease in the level of triglycerides in the blood. Evidence: TAS. Frequency: Frequent (HP:0040282). (ORPHA:14)
- Decreased circulating vitamin D concentration (HP:0100512): The concentration of vitamin D in the blood circulation is below the lower limit of normal. Evidence: TAS. Frequency: Frequent (HP:0040282). (ORPHA:14)
- Rod-cone dystrophy (HP:0000510): An inherited retinal disease subtype in which the rod photoreceptors appear to be more severely affected than the cone photoreceptors. Typical presentation is with nyctalopia (due to rod dysfunction) followed by loss of mid-peripheral field of vision, which gradually extends and leaves many patients with a small central island of vision due to the preservation of macular cones. Evidence: TAS. Frequency: Occasional (HP:0040283). (ORPHA:14)
- Scotoma (HP:0000575): A regional and pathological increase of the light detection threshold in any region of the visual field surrounded by a field of normal or relatively well-preserved vision. Evidence: TAS. Frequency: Occasional (HP:0040283). (ORPHA:14)
- Osteopenia (HP:0000938): Osteopenia is a term to define bone density that is not normal but also not as low as osteoporosis. By definition from the World Health Organization osteopenia is defined by bone densitometry as a T score -1 to -2.5. Evidence: TAS. Frequency: Occasional (HP:0040283). (ORPHA:14)
- Ataxia (HP:0001251): Ataxia refers to impaired coordination of voluntary muscle movement. Cerebellar ataxia refers to ataxia due to dysfunction of the cerebellum. This causes a variety of elementary neurological deficits including asynergy (lack of coordination between muscles, limbs and joints), dysmetria (lack of ability to judge distances that can lead to under- or overshoot in grasping movements), and dysdiadochokinesia (inability to perform rapid movements requiring antagonizing muscle groups to be switched on and off repeatedly). Evidence: TAS. Frequency: Occasional (HP:0040283). (ORPHA:14)
- Dysarthria (HP:0001260): Dysarthric speech is a general description referring to a neurological speech disorder characterized by poor articulation. Depending on the involved neurological structures, dysarthria may be further classified as spastic, flaccid, ataxic, hyperkinetic and hypokinetic, or mixed. Evidence: TAS. Frequency: Occasional (HP:0040283). (ORPHA:14)
- Dysmetria (HP:0001310): A type of ataxia characterized by the inability to carry out movements with the correct range and motion across the plane of more than one joint related to incorrect estimation of the distances required for targeted movements. Evidence: TAS. Frequency: Occasional (HP:0040283). (ORPHA:14)
- Hepatic steatosis (HP:0001397): Steatosis is a term used to denote lipid accumulation within hepatocytes. Evidence: TAS. Frequency: Occasional (HP:0040283). (ORPHA:14)
- Pes cavus (HP:0001761): An increase in height of the medial longitudinal arch of the foot that does not flatten on weight bearing (i.e., a distinctly hollow form of the sole of the foot when it is bearing weight). Evidence: TAS. Frequency: Occasional (HP:0040283). (ORPHA:14)
- Talipes equinovarus (HP:0001762): Talipes equinovarus (also called clubfoot) typically has four main components: inversion and adduction of the forefoot; inversion of the heel and hindfoot; equinus (limitation of extension) of the ankle and subtalar joint; and internal rotation of the leg. Evidence: TAS. Frequency: Occasional (HP:0040283). (ORPHA:14)
- Vomiting (HP:0002013): Forceful ejection of the contents of the stomach through the mouth by means of a series of involuntary spasmic contractions. Evidence: TAS. Frequency: Occasional (HP:0040283). (ORPHA:14)
- Gait ataxia (HP:0002066): A type of ataxia characterized by the impairment of the ability to coordinate the movements required for normal walking. Gait ataxia is characteirzed by a wide-based staggering gait with a tendency to fall. Evidence: TAS. Frequency: Occasional (HP:0040283). (ORPHA:14)
- Broad-based gait (HP:0002136): An abnormal gait pattern in which persons stand and walk with their feet spaced widely apart. This is often a component of cerebellar ataxia. Evidence: TAS. Frequency: Occasional (HP:0040283). (ORPHA:14)
- Hepatomegaly (HP:0002240): Abnormally increased size of the liver. Evidence: TAS. Frequency: Occasional (HP:0040283). (ORPHA:14)
- Positive Romberg sign (HP:0002403): The patient stands with the feet placed together and balance and is asked to close his or her eyes. A loss of balance upon eye closure is a positive Romberg sign and is interpreted as indicating a deficit in proprioception. Evidence: TAS. Frequency: Occasional (HP:0040283). (ORPHA:14)
- Upper motor neuron dysfunction (HP:0002493): A functional anomaly of the upper motor neuron. The upper motor neurons are neurons of the primary motor cortex which project to the brainstem and spinal chord via the corticonuclear, corticobulbar and corticospinal (pyramidal) tracts. They are involved in control of voluntary movements. Dysfunction leads to weakness, impairment of fine motor movements, spasticity, hyperreflexia and abnormal pyramidal signs. Evidence: TAS. Frequency: Occasional (HP:0040283). (ORPHA:14)
- Impaired vibratory sensation (HP:0002495): A decrease in the ability to perceive vibration. Clinically, this is usually tested with a tuning fork which vibrates at 128 Hz and is applied to bony prominences such as the malleoli at the ankles or the metacarpal-phalangeal joints. There is a slow decay of vibration from the tuning fork. The degree of vibratory sense loss can be crudely estimated by counting the number of seconds that the examiner can perceive the vibration longer than the patient. Evidence: TAS. Frequency: Occasional (HP:0040283). (ORPHA:14)
- Kyphoscoliosis (HP:0002751): An abnormal curvature of the spine in both a coronal (lateral) and sagittal (back-to-front) plane. Evidence: TAS. Frequency: Occasional (HP:0040283). (ORPHA:14)
- Elevated circulating hepatic transaminase concentration (HP:0002910): Elevations of the levels of SGOT and SGPT in the serum. SGOT (serum glutamic oxaloacetic transaminase) and SGPT (serum glutamic pyruvic transaminase) are transaminases primarily found in the liver and heart and are released into the bloodstream as the result of liver or heart damage. SGOT and SGPT are used clinically mainly as markers of liver damage. Evidence: TAS. Frequency: Occasional (HP:0040283). (ORPHA:14)
- Myopathy (HP:0003198): A disorder of muscle unrelated to impairment of innervation or neuromuscular junction. Evidence: TAS. Frequency: Occasional (HP:0040283). (ORPHA:14)
- Steppage gait (HP:0003376): An abnormal gait pattern that arises from weakness of the pretibial and peroneal muscles due to a lower motor neuron lesion. Affected patients have footdrop and are unable to dorsiflex and evert the foot. The leg is lifted high on walking so that the toes clear the ground, and there may be a slapping noise when the foot strikes the ground again. Evidence: TAS. Frequency: Occasional (HP:0040283). (ORPHA:14)
- Babinski sign (HP:0003487): Upturning of the big toe (and sometimes fanning of the other toes) in response to stimulation of the sole of the foot. If the Babinski sign is present it can indicate damage to the corticospinal tract. Evidence: TAS. Frequency: Occasional (HP:0040283). (ORPHA:14)
- Impaired distal proprioception (HP:0006858): A loss or impairment of the sensation of the relative position of parts of the body and joint position occurring at distal joints. Evidence: TAS. Frequency: Occasional (HP:0040283). (ORPHA:14)
- Fundus hypopigmentation (HP:0007894): Generalized or focal reduced pigmentation of the fundus, evaluated in the context of skin and hair color. Fundoscopy may reveal a low level pigment. Evidence: TAS. Frequency: Occasional (HP:0040283). (ORPHA:14)
- Prolonged prothrombin time (HP:0008151): Increased time to coagulation in the prothrombin time test, which is a measure of the extrinsic pathway of coagulation. The results of the prothrombin time test are often expressed in terms of the International normalized ratio (INR), which is calculated as a ratio of the patient's prothrombin time (PT) to a control PT standardized for the potency of the thromboplastin reagent developed by the World Health Organization (WHO) using the formula: INR is equal to Patient PT divided by Control PT. Evidence: TAS. Frequency: Occasional (HP:0040283). (ORPHA:14)
- Distal lower limb muscle weakness (HP:0009053): Reduced strength of the distal musculature of the legs. Evidence: TAS. Frequency: Occasional (HP:0040283). (ORPHA:14)
- Impaired proprioception (HP:0010831): A loss or impairment of the sensation of the relative position of parts of the body and joint position. Evidence: TAS. Frequency: Occasional (HP:0040283). (ORPHA:14)
- Decreased erythrocyte sedimentation rate (HP:0025022): A reduced erythrocyte sedimentation rate (ESR). The ESR is a test that measures the distance that erythrocytes have fallen after one hour in a vertical column of anticoagulated blood under the influence of gravity. The ESR is a nonspecific finding. A decreased ESR may be seen in polycythemia or in certain blood diseases in which red blood cells have an irregular or smaller shape that causes slower settling. Evidence: TAS. Frequency: Occasional (HP:0040283). (ORPHA:14)
- Ptosis (HP:0000508): The upper eyelid margin is positioned 3 mm or more lower than usual and covers the superior portion of the iris (objective); or, the upper lid margin obscures at least part of the pupil (subjective). Evidence: TAS. Frequency: Very rare (HP:0040284). (ORPHA:14)
- Ophthalmoplegia (HP:0000602): Paralysis of one or more extraocular muscles that are responsible for eye movements. Evidence: TAS. Frequency: Very rare (HP:0040284). (ORPHA:14)
- Blindness (HP:0000618): Blindness is the condition of lacking visual perception defined as a profound reduction in visual perception. On the 6m visual acuity scale, blindness is defined as less than 3/60. On the 20ft visual acuity scale, blindness is defined as less than 20/400. On the decimal visual acuity scale, blindness is defined as less than 0.05. Blindness is typically characterized by a visual field of no greater than 10 degrees in radius around central fixation. Evidence: TAS. Frequency: Very rare (HP:0040284). (ORPHA:14)
- Hypothyroidism (HP:0000821): Deficiency of thyroid hormone. Evidence: TAS. Frequency: Very rare (HP:0040284). (ORPHA:14)
- Keratoconjunctivitis sicca (HP:0001097): Dryness of the eye related to deficiency of the tear film components (aqueous, mucin, or lipid), lid surface abnormalities, or epithelial abnormalities. Keratoconjunctivitis sicca often results in a scratchy or sandy sensation (foreign body sensation) in the eyes, and may also be associated with itching, inability to produce tears, photosensitivity, redness, pain, and difficulty in moving the eyelids. Evidence: TAS. Frequency: Very rare (HP:0040284). (ORPHA:14)
- Cirrhosis (HP:0001394): A chronic disorder of the liver in which liver tissue becomes scarred and is partially replaced by regenerative nodules and fibrotic tissue resulting in loss of liver function. Evidence: TAS. Frequency: Very rare (HP:0040284). (ORPHA:14)
- Hepatic fibrosis (HP:0001395): The presence of excessive fibrous connective tissue in the liver. Fibrosis is a reparative or reactive process. Evidence: TAS. Frequency: Very rare (HP:0040284). (ORPHA:14)
- Congestive heart failure (HP:0001635): The presence of an abnormality of cardiac function that is responsible for the failure of the heart to pump blood at a rate that is commensurate with the needs of the tissues or a state in which abnormally elevated filling pressures are required for the heart to do so. Heart failure is frequently related to a defect in myocardial contraction. Evidence: TAS. Frequency: Very rare (HP:0040284). (ORPHA:14)
- Cardiomegaly (HP:0001640): Increased size of the heart, clinically defined as an increased transverse diameter of the cardiac silhouette that is greater than or equal to 50% of the transverse diameter of the chest (increased cardiothoracic ratio) on a posterior-anterior projection of a chest radiograph or a computed tomography. Evidence: TAS. Frequency: Very rare (HP:0040284). (ORPHA:14)
- Abnormal bleeding (HP:0001892): An abnormal susceptibility to bleeding, often referred to as a bleeding diathesis. A bleeding diathesis may be related to vascular, platelet and coagulation defects. Evidence: TAS. Frequency: Very rare (HP:0040284). (ORPHA:14)
- Respiratory failure (HP:0002878): A severe form of respiratory insufficiency characterized by inadequate gas exchange such that the levels of oxygen or carbon dioxide cannot be maintained within normal limits. Evidence: TAS. Frequency: Very rare (HP:0040284). (ORPHA:14)
- Corneal ulceration (HP:0012804): Disruption of the epithelial layer of the cornea with involvement of the underlying stroma. Evidence: TAS. Frequency: Very rare (HP:0040284). (ORPHA:14)